- Posterior subcapsular cataract (HP:0007787): A type of cataract affecting the posterior pole of lens immediately adjacent to ('beneath') the Lens capsule. Evidence: IEA. (OMIM:149500)
- Autosomal dominant inheritance (HP:0000006): A mode of inheritance that is observed for traits related to a gene encoded on one of the autosomes (i.e., the human chromosomes 1-22) in which a trait manifests in heterozygotes. In the context of medical genetics, an autosomal dominant disorder is caused when a single copy of the mutant allele is present. Males and females are affected equally, and can both transmit the disorder with a risk of 50% for each child of inheriting the mutant allele. Evidence: IEA. (OMIM:149500)
- Abnormality of the skin (HP:0000951): An abnormality of the skin. Evidence: IEA. (OMIM:149500)
These phenotypes are associated with the disease Kyrle disease (OMIM:149500).